- Obesity (HP:0001513): Accumulation of substantial excess body fat. Evidence: TAS. (OMIM:190430)
- Autosomal dominant inheritance (HP:0000006): A mode of inheritance that is observed for traits related to a gene encoded on one of the autosomes (i.e., the human chromosomes 1-22) in which a trait manifests in heterozygotes. In the context of medical genetics, an autosomal dominant disorder is caused when a single copy of the mutant allele is present. Males and females are affected equally, and can both transmit the disorder with a risk of 50% for each child of inheriting the mutant allele. Evidence: TAS. (OMIM:190430)
These phenotypes are associated with the disease triglyceride storage disease, type 2 (OMIM:190430).